Phenotypes associated with the disease Tryptophanuria with dwarfism (OMIM:276100):
- Severe short stature (HP:0003510): A severe degree of short stature, more than -4 SD from the mean corrected for age and sex. Evidence: IEA. (OMIM:276100)
- Cutaneous photosensitivity (HP:0000992): An increased sensitivity of the skin to light. Photosensitivity may result in a rash upon exposure to the sun (which is known as photodermatosis). Photosensitivity can be diagnosed by phototests in which light is shone on small areas of skin. Evidence: IEA. (OMIM:276100)
- Gait disturbance (HP:0001288): The term gait disturbance can refer to any disruption of the ability to walk. Evidence: IEA. (OMIM:276100)
- Tryptophanuria (HP:0003361): An increased concentration of tryptophan in the urine. Evidence: IEA. (OMIM:276100)
- Ataxia (HP:0001251): Ataxia refers to impaired coordination of voluntary muscle movement. Cerebellar ataxia refers to ataxia due to dysfunction of the cerebellum. This causes a variety of elementary neurological deficits including asynergy (lack of coordination between muscles, limbs and joints), dysmetria (lack of ability to judge distances that can lead to under- or overshoot in grasping movements), and dysdiadochokinesia (inability to perform rapid movements requiring antagonizing muscle groups to be switched on and off repeatedly). Evidence: IEA. (OMIM:276100)
- Autosomal recessive inheritance (HP:0000007): A mode of inheritance that is observed for traits related to a gene encoded on one of the autosomes (i.e., the human chromosomes 1-22) in which a trait manifests in individuals with two pathogenic alleles, either homozygotes (two copies of the same mutant allele) or compound heterozygotes (whereby each copy of a gene has a distinct mutant allele). Evidence: IEA. (OMIM:276100)
- Conjunctival telangiectasia (HP:0000524): The presence of small (ca. 0.5-1.0 mm) dilated blood vessels near the surface of the mucous membranes of the conjunctiva. Evidence: IEA. (OMIM:276100)
- Intellectual disability (HP:0001249): The term intellectual disability or intellectual developmental disorder is used to describe significantly sub-average intellectual and adaptive functioning based on clinical assessment and as measured by individually administered, appropriately normed, standardized and validated tests of intellectual functioning and adaptive behavior, with onset during the developmental period from infancy through adolescence. Evidence: IEA. (OMIM:276100)